Phenotypes associated with the disease developmental and epileptic encephalopathy, 15 (OMIM:615006):
- Bilateral tonic-clonic seizure (HP:0002069): A bilateral tonic-clonic seizure is a seizure defined by a tonic (bilateral increased tone, lasting seconds to minutes) and then a clonic (bilateral sustained rhythmic jerking) phase. Evidence: PCS. Frequency: 1/4. (PMID:23252400)
- Primitive reflex (HP:0002476): The primitive reflexes are a group of behavioral motor responses which are found in normal early development, are subsequently inhibited, but may be released from inhibition by cerebral, usually frontal, damage. They are thus part of a broader group of reflexes which reflect release phenomena, such as exaggerated stretch reflexes and extensor plantars. They do however involve more complex motor responses than such simple stretch reflexes, and are often a normal feature in the neonate or infant. Evidence: IEA. Frequency: 1/1. (OMIM:615006)
- Hypsarrhythmia (HP:0002521): Hypsarrhythmia is abnormal interictal high amplitude waves and a background of irregular spikes. There is continuous (during wakefulness), high-amplitude (>200 Hz), generalized polymorphic slowing with no organized background and multifocal spikes demonstrated by electroencephalography (EEG). Evidence: IEA. Frequency: 1/1. (OMIM:615006)
- Inability to walk (HP:0002540): Incapability to ambulate. Evidence: IEA. (OMIM:615006)
- Focal clonic seizure (HP:0002266): A focal clonic seizure is a type of focal motor seizure characterized by sustained rhythmic jerking, that is regularly repetitive. Evidence: PCS. Frequency: 1/4. (PMID:23252400)
- Atonic seizure (HP:0010819): Atonic seizure is a type of motor seizure characterized by a sudden loss or diminution of muscle tone without apparent preceding myoclonic or tonic event lasting about 1 to 2 seconds, involving head, trunk, jaw, or limb musculature. Evidence: PCS. Frequency: 2/4. (PMID:23252400)
- Profound intellectual disability (HP:0002187): Profound intellectual disability (ID) is defined as a type of ID characterized by profoundly sub-average adaptive functioning and intellectual functioning, with an intelligence quotient (IQ) below 20. Evidence: TAS. (OMIM:615006)
- Hypotonia (HP:0001252): Hypotonia is an abnormally low muscle tone (the amount of tension or resistance to movement in a muscle). Even when relaxed, muscles have a continuous and passive partial contraction which provides some resistance to passive stretching. Hypotonia thus manifests as diminished resistance to passive stretching. Hypotonia is not the same as muscle weakness, although the two conditions can co-exist. Evidence: IEA. Frequency: 1/1. (OMIM:615006)
- Infantile onset (HP:0003593): Onset of signs or symptoms of disease between 28 days to one year of life. Evidence: PCS. Frequency: 4/4. (PMID:23252400)
- Myoclonic seizure (HP:0032794): A myoclonic seizure is a type of motor seizure characterized by sudden, brief (<100 ms) involuntary single or multiple contraction of muscles or muscle groups of variable topography (axial, proximal limb, distal). Myoclonus is less regularly repetitive and less sustained than is clonus. Evidence: PCS. Frequency: 1/4. (PMID:23252400)
- Severe global developmental delay (HP:0011344): A severe delay in the achievement of motor or mental milestones in the domains of development of a child. Evidence: PCS. Frequency: 4/4. (PMID:23252400)
- Epileptic spasm (HP:0011097): A sudden flexion, extension, or mixed extension-flexion of predominantly proximal and truncal muscles that is usually more sustained than a myoclonic movement but not as sustained as a tonic seizure. Limited forms may occur: Grimacing, head nodding, or subtle eye movements. Epileptic spasms frequently occur in clusters. Infantile spasms are the best known form, but spasms can occur at all ages. Evidence: IEA. Frequency: 4/4. (OMIM:615006)
- Irritability (HP:0000737): An emotional state characterized by negative feelings of heightened frustration, annoyance, or feeling upset, often triggered by internal factors (e.g., fatigue, hunger, unfulfilled desires) or external factors (e.g., social or environmental challenges). Irritability may be unpredictable, and is accompanied by a lowered threshold for emotional reactivity and observable features (speech, facial expressions, or psychomotor activity). Evidence: IEA. Frequency: 1/1. (OMIM:615006)
- Reduced eye contact (HP:0000817): A reduced frequency or duration of eye contact. Evidence: IEA. Frequency: 1/1. (OMIM:615006)
- Tonic seizure (HP:0032792): A tonic seizure is a type of motor seizure characterized by unilateral or bilateral limb stiffening or elevation, often with neck stiffening. Evidence: PCS. Frequency: 1/4. (PMID:23252400)
- Autosomal recessive inheritance (HP:0000007): A mode of inheritance that is observed for traits related to a gene encoded on one of the autosomes (i.e., the human chromosomes 1-22) in which a trait manifests in individuals with two pathogenic alleles, either homozygotes (two copies of the same mutant allele) or compound heterozygotes (whereby each copy of a gene has a distinct mutant allele). Evidence: PCS. (PMID:23252400)
- Epileptic encephalopathy (HP:0200134): A condition in which epileptiform abnormalities are believed to contribute to the progressive disturbance in cerebral function. Epileptic encephalaopathy is characterized by (1) electrographic EEG paroxysmal activity that is often aggressive, (2) seizures that are usually multiform and intractable, (3) cognitive, behavioral and neurological deficits that may be relentless, and (4) sometimes early death. Evidence: IEA. Frequency: 4/4. (OMIM:615006)